Phenotypes associated with the disease OSLAM syndrome (ORPHA:2760):
- Carious teeth (HP:0000670): Caries is a multifactorial bacterial infection affecting the structure of the tooth. This term has been used to describe the presence of more than expected dental caries. Evidence: TAS. Frequency: Very frequent (HP:0040281). (ORPHA:2760)
- Abnormality of neutrophils (HP:0001874): A neutrophil abnormality. Evidence: TAS. Frequency: Very frequent (HP:0040281). (ORPHA:2760)
- Osteosarcoma (HP:0002669): A malignant bone tumor that usually develops during adolescence and usually affects the long bones including the tibia, femur, and humerus. The typical symptoms of osteosarcoma comprise bone pain, fracture, limitation of motion, and tenderness or swelling at the site of the tumor. Evidence: TAS. Frequency: Very frequent (HP:0040281). (ORPHA:2760)
- Radioulnar synostosis (HP:0002974): An abnormal osseous union (fusion) between the radius and the ulna. Evidence: TAS. Frequency: Occasional (HP:0040283). (ORPHA:2760)
- Clinodactyly of the 5th finger (HP:0004209): Clinodactyly refers to a bending or curvature of the fifth finger in the radial direction (i.e., towards the 4th finger). Evidence: TAS. Frequency: Occasional (HP:0040283). (ORPHA:2760)
- Short stature (HP:0004322): A height below that which is expected according to age and gender norms. Although there is no universally accepted definition of short stature, many refer to "short stature" as height more than 2 standard deviations below the mean for age and gender (or below the 3rd percentile for age and gender dependent norms). Evidence: TAS. Frequency: Frequent (HP:0040282). (ORPHA:2760)
- Increased mean corpuscular volume (HP:0005518): Larger than normal size of erythrocytes. Evidence: TAS. Frequency: Very frequent (HP:0040281). (ORPHA:2760)